- Recurrent infections (HP:0002719): Increased susceptibility to infections as manifested by repeated bouts of infection. Evidence: TAS. (OMIM:614891)
- Recurrent mycobacterial infections (HP:0011274): Increased susceptibility to mycobacterial infections as manifested by recurrent episodes of mycobacterial infection. Evidence: TAS. (OMIM:614891)
- Autosomal recessive inheritance (HP:0000007): A mode of inheritance that is observed for traits related to a gene encoded on one of the autosomes (i.e., the human chromosomes 1-22) in which a trait manifests in individuals with two pathogenic alleles, either homozygotes (two copies of the same mutant allele) or compound heterozygotes (whereby each copy of a gene has a distinct mutant allele). Evidence: TAS. (OMIM:614891)
- Immunodeficiency (HP:0002721): Failure of the immune system to protect the body adequately from infection, due to the absence or insufficiency of some component process or substance. Evidence: TAS. (OMIM:614891)
These phenotypes are associated with the disease Mendelian susceptibility to mycobacterial diseases due to complete IL12RB1 deficiency (OMIM:614891).